Phenotypes associated with the disease preterm premature rupture of the membranes (OMIM:610504):
- Young adult onset (HP:0011462): Onset of disease at the age of between 16 and 40 years. Evidence: PCS. (PMID:16938879)
- Polygenic inheritance (HP:0010982): A mode of inheritance that depends on a mixture of major and minor genetic determinants possibly together with environmental factors. Diseases inherited in this manner are termed complex diseases. Evidence: PCS. (PMID:16938879)
- Premature rupture of membranes (HP:0001788): Premature rupture of membranes (PROM) is a condition which occurs in pregnancy when the amniotic sac ruptures more than an hour before the onset of labor. Evidence: PCS. (PMID:16938879)